Phenotypes associated with the disease hypertrophic cardiomyopathy 13 (OMIM:613243):
- Juvenile onset (HP:0003621): Onset of signs or symptoms of disease between the age of 5 and 15 years. Evidence: IEA. Frequency: 2/4. (PMID:18572189)
- Ventricular fibrillation (HP:0001663): Uncontrolled contractions of muscles fibers in the left ventricle not producing contraction of the left ventricle. Ventricular fibrillation usually begins with a ventricular premature contraction and a short run of rapid ventricular tachycardia degenerating into uncoordinating ventricular fibrillations. Evidence: TAS. (OMIM:613243)
- Middle age onset (HP:0003596): A type of adult onset with onset of symptoms at the age of 40 to 60 years. Evidence: PCS. Frequency: 2/5. (PMID:11385718;PMID:18572189)
- Concentric hypertrophic cardiomyopathy (HP:0005157): Hypertrophic cardiomyopathy with an symmetrical and concentric pattern of hypertrophy. Evidence: PCS. Frequency: 1/1. (PMID:11385718)
- Biventricular hypertrophy (HP:0200128): Thickening of the heart walls in both ventricles. Evidence: IEA. (OMIM:613243)
- Angina pectoris (HP:0001681): Paroxysmal chest pain that occurs with exertion or stress and is related to myocardial ischemia. Evidence: PCS. Frequency: 2/4. (PMID:18572189)
- Atrial fibrillation (HP:0005110): An atrial arrhythmia characterized by disorganized atrial activity without discrete P waves on the surface EKG, but instead by an undulating baseline or more sharply circumscribed atrial deflections of varying amplitude an frequency ranging from 350 to 600 per minute. Evidence: PCS. Frequency: 1/5. (PMID:11385718;PMID:18572189)
- Left anterior fascicular block (HP:0011711): Conduction block in the anterior division of the left bundle branch of the bundle of His. Evidence: PCS. Frequency: 1/1. (PMID:11385718)
- Dyspnea (HP:0002094): Difficult or labored breathing. Dyspnea is a subjective feeling only the patient can rate, e.g., on a Borg scale. Evidence: PCS. Frequency: 1/4. (PMID:11385718)
- Complete right bundle branch block (HP:0011712): A conduction block of the right branch of the bundle of His. This manifests as a prolongation of the QRS complex (greater than 0.12 s) with delayed activation of the right ventricle and terminal delay on the EKG. Evidence: PCS. Frequency: 1/1. (PMID:11385718)
- Reduced left ventricular ejection fraction (HP:0012664): A diminution of the volumetric fraction of blood pumped out of the ventricle with each cardiac cycle. Evidence: PCS. Frequency: 0/1. (PMID:11385718)
- Hypertrophic cardiomyopathy (HP:0001639): Hypertrophic cardiomyopathy (HCM) is defined by the presence of increased ventricular wall thickness or mass in the absence of loading conditions (hypertension, valve disease) sufficient to cause the observed abnormality. Evidence: PCS. Frequency: 4/4. (PMID:18572189)
- ST segment depression (HP:0012250): An electrocardiographic anomaly in which the ST segment is observed to be located inferior to the isoelectric line. Evidence: IEA. (OMIM:613243)
- Young adult onset (HP:0011462): Onset of disease at the age of between 16 and 40 years. Evidence: PCS. Frequency: 1/4. (PMID:18572189)
- Chest pain (HP:0100749): An unpleasant sensation characterized by physical discomfort (such as pricking, throbbing, or aching) localized to the chest. Evidence: PCS. (PMID:18572189)
- Syncope (HP:0001279): A transient loss of consciousness (i.e., characterized by a rapid onset, a short duration, and a spontaneous and complete recovery) due to cerebral hypoperfusion. Evidence: PCS. Frequency: 1/4. (PMID:18572189)
- Autosomal dominant inheritance (HP:0000006): A mode of inheritance that is observed for traits related to a gene encoded on one of the autosomes (i.e., the human chromosomes 1-22) in which a trait manifests in heterozygotes. In the context of medical genetics, an autosomal dominant disorder is caused when a single copy of the mutant allele is present. Males and females are affected equally, and can both transmit the disorder with a risk of 50% for each child of inheriting the mutant allele. Evidence: TAS. (OMIM:613243)
- Exertional dyspnea (HP:0002875): Perceived difficulty to breathe that occurs with exercise or exertion and improves with rest. Evidence: PCS. Frequency: 1/1. (PMID:11385718)